- Hydrocephalus (HP:0000238): Hydrocephalus is an active distension of the ventricular system of the brain resulting from inadequate passage of CSF from its point of production within the cerebral ventricles to its point of absorption into the systemic circulation. Evidence: TAS. Frequency: Occasional (HP:0040283). (ORPHA:137817)
- Tinnitus (HP:0000360): Tinnitus is an auditory perception that can be described as the experience of sound, in the ear or in the head, in the absence of external acoustic stimulation. Evidence: TAS. Frequency: Very frequent (HP:0040281). (ORPHA:137817)
- Hearing impairment (HP:0000365): A decreased magnitude of the sensory perception of sound. Evidence: TAS. Frequency: Very frequent (HP:0040281). (ORPHA:137817)
- Abnormality of the eye (HP:0000478): Any abnormality of the eye, including location, spacing, and intraocular abnormalities. Evidence: TAS. Frequency: Very frequent (HP:0040281). (ORPHA:137817)
- Abnormality of vision (HP:0000504): Abnormality of eyesight (visual perception). Evidence: TAS. Frequency: Very frequent (HP:0040281). (ORPHA:137817)
- Sensory neuropathy (HP:0000763): Peripheral neuropathy affecting the sensory nerves. Evidence: TAS. Frequency: Very frequent (HP:0040281). (ORPHA:137817)
- Anhidrosis (HP:0000970): Inability to sweat. Evidence: TAS. Frequency: Frequent (HP:0040282). (ORPHA:137817)
- Hyporeflexia (HP:0001265): Reduction of neurologic reflexes such as the knee-jerk reaction. Evidence: TAS. Frequency: Very frequent (HP:0040281). (ORPHA:137817)
- Meningitis (HP:0001287): Inflammation of the meninges. Evidence: TAS. Frequency: Very frequent (HP:0040281). (ORPHA:137817)
- Muscle weakness (HP:0001324): Reduced strength of muscles. Evidence: TAS. Frequency: Very frequent (HP:0040281). (ORPHA:137817)
- Migraine (HP:0002076): Migraine is a chronic neurological disorder characterized by episodic attacks of headache and associated symptoms. Evidence: TAS. Frequency: Occasional (HP:0040283). (ORPHA:137817)
- Arthralgia (HP:0002829): Joint pain. Evidence: TAS. Frequency: Very frequent (HP:0040281). (ORPHA:137817)
- Urinary bladder sphincter dysfunction (HP:0002839): Abnormal function of a sphincter of the urinary bladder. Evidence: TAS. Frequency: Occasional (HP:0040283). (ORPHA:137817)
- Paresthesia (HP:0003401): Abnormal sensations such as tingling, pricking, or numbness of the skin with no apparent physical cause. Evidence: TAS. Frequency: Very frequent (HP:0040281). (ORPHA:137817)
- Fatigue (HP:0012378): A subjective feeling of tiredness characterized by a lack of energy and motivation. Evidence: TAS. Frequency: Occasional (HP:0040283). (ORPHA:137817)
These phenotypes are associated with the disease Arachnoiditis (ORPHA:137817).